Phenotypes associated with the disease Microcephaly-microcornea syndrome, Seemanova type (ORPHA:2528):
- Hypogonadism (HP:0000135): A decreased functionality of the gonad. Evidence: TAS. Frequency: Very frequent (HP:0040281). (ORPHA:2528)
- Narrow mouth (HP:0000160): Distance between the commissures of the mouth more than 2 SD below the mean. Alternatively, an apparently decreased width of the oral aperture (subjective). Evidence: TAS. Frequency: Very frequent (HP:0040281). (ORPHA:2528)
- High palate (HP:0000218): Height of the palate more than 2 SD above the mean (objective) or palatal height at the level of the first permanent molar more than twice the height of the teeth (subjective). Evidence: TAS. Frequency: Very frequent (HP:0040281). (ORPHA:2528)
- Brachycephaly (HP:0000248): An abnormality of skull shape characterized by a decreased anterior-posterior diameter. That is, a cephalic index greater than 81%. Alternatively, an apparently shortened anteroposterior dimension (length) of the head compared to width. Evidence: TAS. Frequency: Very frequent (HP:0040281). (ORPHA:2528)
- Microcephaly (HP:0000252): Head circumference below 2 standard deviations below the mean for age and gender. Evidence: TAS. Frequency: Very frequent (HP:0040281). (ORPHA:2528)
- Retrognathia (HP:0000278): An abnormality in which the mandible is mislocalised posteriorly. Evidence: TAS. Frequency: Very frequent (HP:0040281). (ORPHA:2528)
- Epicanthus (HP:0000286): A fold of skin starting above the medial aspect of the upper eyelid and arching downward to cover, pass in front of and lateral to the medial canthus. Evidence: TAS. Frequency: Very frequent (HP:0040281). (ORPHA:2528)
- Microcornea (HP:0000482): A congenital abnormality of the cornea in which the cornea and the anterior segment of the eye are smaller than normal. The horizontal diameter of the cornea does not reach 10 mm even in adulthood. Evidence: TAS. Frequency: Very frequent (HP:0040281). (ORPHA:2528)
- Cataract (HP:0000518): A cataract is an opacity or clouding that develops in the crystalline lens of the eye or in its capsule. Evidence: TAS. Frequency: Very frequent (HP:0040281). (ORPHA:2528)
- Microphthalmia (HP:0000568): A developmental anomaly characterized by abnormal smallness of one or both eyes. Evidence: TAS. Frequency: Very frequent (HP:0040281). (ORPHA:2528)
- Upslanted palpebral fissure (HP:0000582): The palpebral fissure inclination is more than two standard deviations above the mean for age (objective); or, the inclination of the palpebral fissure is greater than typical for age. Evidence: TAS. Frequency: Very frequent (HP:0040281). (ORPHA:2528)
- Growth delay (HP:0001510): A deficiency or slowing down of growth pre- and postnatally. Evidence: TAS. Frequency: Very frequent (HP:0040281). (ORPHA:2528)
- Progressive spasticity (HP:0002191): Spasticity that increases in degree with time. Evidence: TAS. Frequency: Very frequent (HP:0040281). (ORPHA:2528)
- Short stature (HP:0004322): A height below that which is expected according to age and gender norms. Although there is no universally accepted definition of short stature, many refer to "short stature" as height more than 2 standard deviations below the mean for age and gender (or below the 3rd percentile for age and gender dependent norms). Evidence: TAS. Frequency: Very frequent (HP:0040281). (ORPHA:2528)
- Severe intellectual disability (HP:0010864): Severe intellectual disability (ID) is defined as a type of ID characterized by severely sub-average adaptive functioning and intellectual functioning, with an intelligence quotient (IQ) the range of 20-34. Evidence: TAS. Frequency: Very frequent (HP:0040281). (ORPHA:2528)